- Abnormality of the dentition (HP:0000164): Any abnormality of the teeth. Evidence: PCS. Frequency: 0/19. (PMID:20393562)
- Abnormal nail morphology (HP:0001597): Abnormal structure or appearance of the nail. Evidence: PCS. Frequency: 0/19. (PMID:20393562)
- Sparse body hair (HP:0002231): Sparseness of the body hair. Evidence: PCS. (PMID:20393562)
- Childhood onset (HP:0011463): Onset of disease at the age of between 1 and 5 years. Evidence: PCS. (PMID:20393562)
- Sparse eyelashes (HP:0000653): Decreased density/number of eyelashes. Evidence: PCS. Frequency: 0/19. (PMID:20393562)
- Sparse eyebrow (HP:0045075): Decreased density/number of eyebrow hairs. Evidence: PCS. Frequency: 0/19. (PMID:20393562)
- Sparse hair (HP:0008070): Reduced density of hairs. Evidence: PCS. Frequency: 19/19. Onset: Childhood onset (HP:0011463). (PMID:20393562)
- Autosomal dominant inheritance (HP:0000006): A mode of inheritance that is observed for traits related to a gene encoded on one of the autosomes (i.e., the human chromosomes 1-22) in which a trait manifests in heterozygotes. In the context of medical genetics, an autosomal dominant disorder is caused when a single copy of the mutant allele is present. Males and females are affected equally, and can both transmit the disorder with a risk of 50% for each child of inheriting the mutant allele. Evidence: PCS. (PMID:20393562)
- Sparse pubic hair (HP:0002225): Reduced number or density of pubic hair. Evidence: PCS. (PMID:20393562)
- Sparse axillary hair (HP:0002215): Reduced number or density of axillary hair. Evidence: PCS. (PMID:20393562)
- Abnormality of the skin (HP:0000951): An abnormality of the skin. Evidence: PCS. Frequency: 0/19. (PMID:20393562)
These phenotypes are associated with the disease hypotrichosis 1 (OMIM:605389).